- Wide mouth (HP:0000154): Distance between the oral commissures more than 2 SD above the mean. Alternatively, an apparently increased width of the oral aperture (subjective). Evidence: TAS. Frequency: Very frequent (HP:0040281). (ORPHA:50814)
- High palate (HP:0000218): Height of the palate more than 2 SD above the mean (objective) or palatal height at the level of the first permanent molar more than twice the height of the teeth (subjective). Evidence: TAS. Frequency: Occasional (HP:0040283). (ORPHA:50814)
- Thin vermilion border (HP:0000233): Height of the vermilion of the medial part of the lip more than 2 SD below the mean, or apparently reduced height of the vermilion of the lip in the frontal view. The vermilion is the red part of the lips (and confusingly, the vermilion itself is also often referred to as being equivalent the lips). Evidence: TAS. Frequency: Very frequent (HP:0040281). (ORPHA:50814)
- Large fontanelles (HP:0000239): In newborns, the two frontal bones, two parietal bones, and one occipital bone are joined by fibrous sutures, which form a small posterior fontanelle, and a larger, diamond-shaped anterior fontanelle. These regions allow for the skull to pass the birth canal and for later growth. The fontanelles gradually ossify, whereby the posterior fontanelle usually closes by eight weeks and the anterior fontanelle by the 9th to 16th month of age. Large fontanelles are diagnosed if the fontanelles are larger than age-dependent norms. Evidence: TAS. Frequency: Very frequent (HP:0040281). (ORPHA:50814)
- Hypertelorism (HP:0000316): Interpupillary distance more than 2 SD above the mean (alternatively, the appearance of an increased interpupillary distance or widely spaced eyes). Evidence: TAS. Frequency: Very frequent (HP:0040281). (ORPHA:50814)
- Smooth philtrum (HP:0000319): Flat skin surface, with no ridge formation in the central region of the upper lip between the nasal base and upper vermilion border. Evidence: TAS. Frequency: Very frequent (HP:0040281). (ORPHA:50814)
- Hypoplasia of the maxilla (HP:0000327): Abnormally small dimension of the Maxilla. Usually creating a malocclusion or malalignment between the upper and lower teeth or resulting in a deficient amount of projection of the base of the nose and lower midface region. Evidence: TAS. Frequency: Very frequent (HP:0040281). (ORPHA:50814)
- Prominent supraorbital ridges (HP:0000336): Greater than average forward and/or lateral protrusion of the supraorbital portion of the frontal bones. Evidence: TAS. Frequency: Very frequent (HP:0040281). (ORPHA:50814)
- Long philtrum (HP:0000343): Distance between nasal base and midline upper lip vermilion border more than 2 SD above the mean. Alternatively, an apparently increased distance between nasal base and midline upper lip vermilion border. Evidence: TAS. Frequency: Very frequent (HP:0040281). (ORPHA:50814)
- Prominent nasal bridge (HP:0000426): Anterior positioning of the nasal root in comparison to the usual positioning for age. Evidence: TAS. Frequency: Very frequent (HP:0040281). (ORPHA:50814)
- Wide nose (HP:0000445): Interalar distance more than two standard deviations above the mean for age, i.e., an apparently increased width of the nasal base and alae. Evidence: TAS. Frequency: Very frequent (HP:0040281). (ORPHA:50814)
- Carious teeth (HP:0000670): Caries is a multifactorial bacterial infection affecting the structure of the tooth. This term has been used to describe the presence of more than expected dental caries. Evidence: TAS. Frequency: Very frequent (HP:0040281). (ORPHA:50814)
- Delayed eruption of teeth (HP:0000684): Delayed tooth eruption, which can be defined as tooth eruption more than 2 SD beyond the mean eruption age. Evidence: TAS. Frequency: Very frequent (HP:0040281). (ORPHA:50814)
- Hypoplasia of teeth (HP:0000685): Developmental hypoplasia of teeth. Evidence: TAS. Frequency: Very frequent (HP:0040281). (ORPHA:50814)
- Microdontia (HP:0000691): Decreased size of the teeth, which can be defined as a mesiodistal tooth diameter (width) more than 2 SD below mean. Alternatively, an apparently decreased maximum width of tooth. Evidence: TAS. Frequency: Very frequent (HP:0040281). (ORPHA:50814)
- Delayed speech and language development (HP:0000750): A degree of language development that is significantly below the norm for a child of a specified age. Evidence: TAS. Frequency: Occasional (HP:0040283). (ORPHA:50814)
- Narrow chest (HP:0000774): Reduced width of the chest from side to side, associated with a reduced distance from the sternal notch to the tip of the shoulder. Evidence: TAS. Frequency: Frequent (HP:0040282). (ORPHA:50814)
- Hyperpigmentation of the skin (HP:0000953): A darkening of the skin related to an increase in melanin production and deposition. Evidence: TAS. Frequency: Frequent (HP:0040282). (ORPHA:50814)
- Abnormal skin pigmentation (HP:0001000): An abnormality of the pigmentation of the skin. Evidence: TAS. Frequency: Frequent (HP:0040282). (ORPHA:50814)
- Pes planus (HP:0001763): A foot where the longitudinal arch of the foot is in contact with the ground or floor when the individual is standing; or, in a patient lying supine, a foot where the arch is in contact with the surface of a flat board pressed against the sole of the foot by the examiner with a pressure similar to that expected from weight bearing; or, the height of the arch is reduced. Evidence: TAS. Frequency: Frequent (HP:0040282). (ORPHA:50814)
- Frontal bossing (HP:0002007): Bilateral bulging of the lateral frontal bone prominences with relative sparing of the midline. Evidence: TAS. Frequency: Very frequent (HP:0040281). (ORPHA:50814)
- Coarse hair (HP:0002208): Hair shafts are rough in texture. Evidence: TAS. Frequency: Very frequent (HP:0040281). (ORPHA:50814)
- Brittle hair (HP:0002299): Fragile, easily breakable hair, i.e., with reduced tensile strength. Evidence: TAS. Frequency: Very frequent (HP:0040281). (ORPHA:50814)
- Scoliosis (HP:0002650): The presence of an abnormal lateral curvature of the spine. Evidence: TAS. Frequency: Very frequent (HP:0040281). (ORPHA:50814)
- Skeletal dysplasia (HP:0002652): A general term describing features characterized by abnormal development of bones and connective tissues. Evidence: TAS. Frequency: Very frequent (HP:0040281). (ORPHA:50814)
- Short stature (HP:0004322): A height below that which is expected according to age and gender norms. Although there is no universally accepted definition of short stature, many refer to "short stature" as height more than 2 standard deviations below the mean for age and gender (or below the 3rd percentile for age and gender dependent norms). Evidence: TAS. Frequency: Very frequent (HP:0040281). (ORPHA:50814)
- Decreased skull ossification (HP:0004331): A reduction in the magnitude or amount of ossification of the skull. Evidence: TAS. Frequency: Very frequent (HP:0040281). (ORPHA:50814)
- Capillary hemangioma (HP:0005306): The presence of a capillary hemangioma, which are hemangiomas with small endothelial spaces. Evidence: TAS. Frequency: Frequent (HP:0040282). (ORPHA:50814)
- Premature loss of teeth (HP:0006480): Exfoliation of a tooth more than 2 SD earlier than the normal age for the deciduous teeth and not related to traume or neglect. Exfoliation of a permanent tooth is per se abnormal. Evidence: TAS. Frequency: Very frequent (HP:0040281). (ORPHA:50814)
- Posterior Y-sutural cataract (HP:0008031): A type of sutural cataract in which the opacity follows the posterior Y suture. Evidence: TAS. Frequency: Very frequent (HP:0040281). (ORPHA:50814)
- Sparse hair (HP:0008070): Reduced density of hairs. Evidence: TAS. Frequency: Very frequent (HP:0040281). (ORPHA:50814)
- Posterior wedging of vertebral bodies (HP:0008444): An abnormality of the shape of vertebrae, such that they are wedge-shaped (narrow towards the back). Evidence: TAS. Frequency: Very frequent (HP:0040281). (ORPHA:50814)
- High iliac wing (HP:0008808): Increased height of the wing (or ala) of the ilium (which is the large expanded portion which bounds the greater pelvis laterally). Evidence: TAS. Frequency: Very frequent (HP:0040281). (ORPHA:50814)
- Joint hypermobility (HP:0001382): The capability that a joint (or a group of joints) has to move, passively and/or actively, beyond normal limits along physiological axes. Evidence: TAS. Frequency: Occasional (HP:0040283). (ORPHA:50814)
These phenotypes are associated with the disease Craniolenticulosutural dysplasia (ORPHA:50814).